Phenotypes associated with the disease enuresis, nocturnal, 1 (OMIM:600631):
- Autosomal dominant inheritance (HP:0000006): A mode of inheritance that is observed for traits related to a gene encoded on one of the autosomes (i.e., the human chromosomes 1-22) in which a trait manifests in heterozygotes. In the context of medical genetics, an autosomal dominant disorder is caused when a single copy of the mutant allele is present. Males and females are affected equally, and can both transmit the disorder with a risk of 50% for each child of inheriting the mutant allele. Evidence: TAS. (OMIM:600631)
- Enuresis nocturna (HP:0010677): Enuresis occurring during sleeping hours. Evidence: TAS. (OMIM:600631)